- Hypoplasia of the maxilla (HP:0000327): Abnormally small dimension of the Maxilla. Usually creating a malocclusion or malalignment between the upper and lower teeth or resulting in a deficient amount of projection of the base of the nose and lower midface region. Evidence: IEA. (OMIM:133900)
- Dental malocclusion (HP:0000689): Dental malocclusion refers to an abnormality of the occlusion, or alignment, of the teeth and the way the upper and lower teeth fit together, resulting in overcrowding of teeth or in abnormal bite patterns. Evidence: IEA. (OMIM:133900)
- Autosomal dominant inheritance (HP:0000006): A mode of inheritance that is observed for traits related to a gene encoded on one of the autosomes (i.e., the human chromosomes 1-22) in which a trait manifests in heterozygotes. In the context of medical genetics, an autosomal dominant disorder is caused when a single copy of the mutant allele is present. Males and females are affected equally, and can both transmit the disorder with a risk of 50% for each child of inheriting the mutant allele. Evidence: IEA. (OMIM:133900)
- Facial asymmetry (HP:0000324): An abnormal difference between the left and right sides of the face. Evidence: IEA. (OMIM:133900)
These phenotypes are associated with the disease hemifacial hypertrophy (OMIM:133900).